Phenotypes associated with the disease microcornea-glaucoma-absent frontal sinuses syndrome (OMIM:156700):
- Microcornea (HP:0000482): A congenital abnormality of the cornea in which the cornea and the anterior segment of the eye are smaller than normal. The horizontal diameter of the cornea does not reach 10 mm even in adulthood. Evidence: IEA. (OMIM:156700)
- Autosomal dominant inheritance (HP:0000006): A mode of inheritance that is observed for traits related to a gene encoded on one of the autosomes (i.e., the human chromosomes 1-22) in which a trait manifests in heterozygotes. In the context of medical genetics, an autosomal dominant disorder is caused when a single copy of the mutant allele is present. Males and females are affected equally, and can both transmit the disorder with a risk of 50% for each child of inheriting the mutant allele. Evidence: IEA. (OMIM:156700)
- Glaucoma (HP:0000501): Glaucoma refers loss of retinal ganglion cells in a characteristic pattern of optic neuropathy usually associated with increased intraocular pressure. Evidence: IEA. (OMIM:156700)
- Absent frontal sinuses (HP:0002688): Aplasia of frontal sinus. Evidence: IEA. (OMIM:156700)